Phenotypes associated with the disease Ebstein anomaly (OMIM:224700):
- Atrial standstill (HP:0025478): Atrial standstill or silent atrium is a rare condition presenting with the absence of electrical and mechanical activity in the atria. It presents with the absence of P waves, bradycardia, and wide QRS complex in the electrocardiogram. Evidence: TAS. (OMIM:224700)
- Atrial fibrillation (HP:0005110): An atrial arrhythmia characterized by disorganized atrial activity without discrete P waves on the surface EKG, but instead by an undulating baseline or more sharply circumscribed atrial deflections of varying amplitude an frequency ranging from 350 to 600 per minute. Evidence: IEA. (OMIM:224700)
- Autosomal recessive inheritance (HP:0000007): A mode of inheritance that is observed for traits related to a gene encoded on one of the autosomes (i.e., the human chromosomes 1-22) in which a trait manifests in individuals with two pathogenic alleles, either homozygotes (two copies of the same mutant allele) or compound heterozygotes (whereby each copy of a gene has a distinct mutant allele). Evidence: IEA. (OMIM:224700)
- Complete right bundle branch block (HP:0011712): A conduction block of the right branch of the bundle of His. This manifests as a prolongation of the QRS complex (greater than 0.12 s) with delayed activation of the right ventricle and terminal delay on the EKG. Evidence: TAS. (OMIM:224700)
- Ventricular preexcitation (HP:0004309): An abnormality in which the cardiac ventricles depolarize too early as a result of an abnormality of cardiac conduction pathways such as an accessory pathway. Evidence: TAS. (OMIM:224700)
- Atrial septal defect (HP:0001631): Atrial septal defect (ASD) is a congenital abnormality of the interatrial septum that enables blood flow between the left and right atria via the interatrial septum. Evidence: IEA. (OMIM:224700)
- Ebstein anomaly of the tricuspid valve (HP:0010316): Ebstein's anomaly refers to an abnormally placed and deformed tricuspid valve characterized by apical displacement of the septal and posterior tricuspid valve leaflets, leading to atrialization of the right ventricle with a variable degree of malformation and displacement of the anterior leaflet. Evidence: IEA. (OMIM:224700)
- Sudden cardiac death (HP:0001645): The heart suddenly and unexpectedly stops beating resulting in death within a short time period (generally within 1 h of symptom onset). Evidence: IEA. (OMIM:224700)